- Autosomal recessive inheritance (HP:0000007): A mode of inheritance that is observed for traits related to a gene encoded on one of the autosomes (i.e., the human chromosomes 1-22) in which a trait manifests in individuals with two pathogenic alleles, either homozygotes (two copies of the same mutant allele) or compound heterozygotes (whereby each copy of a gene has a distinct mutant allele). Evidence: IEA. (OMIM:264050)
- Bowing of the long bones (HP:0006487): A bending or abnormal curvature of a long bone. Evidence: IEA. (OMIM:264050)
- Abnormality of the skin (HP:0000951): An abnormality of the skin. Evidence: IEA. (OMIM:264050)
These phenotypes are associated with the disease prenatal bowing (OMIM:264050).